- Male-limited expression (HP:0001475): Used to refer to a monogenic trait linked to an autosomal locus in which the phenotypic effects of allelic differences are expressed only in the male sex. Evidence: TAS. (OMIM:171000)
- Abnormality of the skeletal system (HP:0000924): An abnormality of the skeletal system. Evidence: IEA. (OMIM:171000)
- Abnormality of the genitourinary system (HP:0000119): The presence of any abnormality of the genitourinary system. Evidence: IEA. (OMIM:171000)
- Autosomal dominant inheritance (HP:0000006): A mode of inheritance that is observed for traits related to a gene encoded on one of the autosomes (i.e., the human chromosomes 1-22) in which a trait manifests in heterozygotes. In the context of medical genetics, an autosomal dominant disorder is caused when a single copy of the mutant allele is present. Males and females are affected equally, and can both transmit the disorder with a risk of 50% for each child of inheriting the mutant allele. Evidence: TAS. (OMIM:171000)
- Dupuytren contracture (HP:0005679): An abnormality of the hand resulting from contracture of the palmar fascia with a fixed flexion deformity of the metacarpophalangeal (MCP) joints and the proximal interphalangeal (PIP) joints. Evidence: IEA. (OMIM:171000)
These phenotypes are associated with the disease Peyronie disease (OMIM:171000).